- Taurodontia (HP:0000679): Increased volume of dental pulp of permanent molar characterized by a crown body-root ratio equal or larger than 1:1 or an elongated pulp chambers and apical displacement of the bifurcation or trifurcation of the roots. Evidence: PCS. Frequency: 6/28. (PMID:26387593)
- Autosomal dominant inheritance (HP:0000006): A mode of inheritance that is observed for traits related to a gene encoded on one of the autosomes (i.e., the human chromosomes 1-22) in which a trait manifests in heterozygotes. In the context of medical genetics, an autosomal dominant disorder is caused when a single copy of the mutant allele is present. Males and females are affected equally, and can both transmit the disorder with a risk of 50% for each child of inheriting the mutant allele. Evidence: PCS. (PMID:26387593)
- Agenesis of permanent teeth (HP:0006349): A congenital defect characterized by the absence of one or more permanent teeth, including oligodontia, hypodontia, and adontia of the of permanent teeth. Evidence: PCS. Frequency: 20/26. (PMID:26387593)
These phenotypes are associated with the disease tooth agenesis, selective, 7 (OMIM:616724).